- Bitemporal hemianopia (HP:0030521). Evidence: TAS. Frequency: Very frequent (HP:0040281). (ORPHA:95613)
- Thunderclap headache (HP:0030907): Severe head pain with sudden onset, reaching its maximum intensity in less than one minute and lasting from one hour to ten days. Evidence: TAS. Frequency: Very frequent (HP:0040281). (ORPHA:95613)
- Diplopia (HP:0000651): Diplopia is a condition in which a single object is perceived as two images, it is also known as double vision. Evidence: TAS. Frequency: Frequent (HP:0040282). (ORPHA:95613)
- Impotence (HP:0000802): Inability to develop or maintain an erection of the penis. Evidence: TAS. Frequency: Frequent (HP:0040282). (ORPHA:95613)
- Hypergonadotropic hypogonadism (HP:0000815): Reduced function of the gonads (testes in males or ovaries in females) associated with excess pituitary gonadotropin secretion and resulting in delayed sexual development and growth delay. Evidence: TAS. Frequency: Frequent (HP:0040282). (ORPHA:95613)
- Hypertension (HP:0000822): The presence of chronic increased pressure in the systemic arterial system. Evidence: TAS. Frequency: Frequent (HP:0040282). (ORPHA:95613)
- Oligomenorrhea (HP:0000876): Infrequent menses (less than 6 per year or more than 35 days between cycles). Evidence: TAS. Frequency: Frequent (HP:0040282). (ORPHA:95613)
- Hypoglycemia (HP:0001943): A decreased concentration of glucose in the blood. Evidence: TAS. Frequency: Frequent (HP:0040282). (ORPHA:95613)
- Nausea and vomiting (HP:0002017): Nausea is a commonly encountered symptom that has been defined as an unpleasant painless subjective feeling that one will imminently vomit. Vomiting has been defined as the forceful expulsion of the contents of the stomach, duodenum, or jejunum through the oral cavity. While nausea and vomiting are often thought to exist on a temporal continuum, this is not always the case. There are situations when severe nausea may be present without emesis and less frequently, when emesis may be present without preceding nausea. Evidence: TAS. Frequency: Frequent (HP:0040282). (ORPHA:95613)
- Headache (HP:0002315): Cephalgia, or pain sensed in various parts of the head, not confined to the area of distribution of any nerve. Evidence: TAS. Frequency: Frequent (HP:0040282). (ORPHA:95613)
- Hypotension (HP:0002615): Low Blood Pressure, vascular hypotension. Evidence: TAS. Frequency: Frequent (HP:0040282). (ORPHA:95613)
- Pituitary adenoma (HP:0002893): A benign epithelial tumor derived from intrinsic cells of the adenohypophysis (anterior pituitary). Evidence: TAS. Frequency: Frequent (HP:0040282). (ORPHA:95613)
- Hyponatremia (HP:0002902): The concentration of sodium in the blood circulation is below the lower limit of normal. Evidence: TAS. Frequency: Frequent (HP:0040282). (ORPHA:95613)
- Cranial nerve paralysis (HP:0006824). Evidence: TAS. Frequency: Frequent (HP:0040282). (ORPHA:95613)
- Reduced circulating prolactin concentration (HP:0008202): A reduced level of prolactin in the blood circulation. Prolactin is a protein hormone that is secreted by lactotrophs in the anterior pituitary and that stimulates mammary gland development and milk production. Evidence: TAS. Frequency: Frequent (HP:0040282). (ORPHA:95613)
- Pituitary hypothyroidism (HP:0008245): A type of hypothyroidism that results from a defect in thyroid-stimulating hormone secretion. Evidence: TAS. Frequency: Frequent (HP:0040282). (ORPHA:95613)
- Adrenocorticotropic hormone deficiency (HP:0011748): A reduced ability to secrete adrenocorticotropic hormone (ACTH), a hormone that stimulates the adrenal cortex to secrete of glucocorticoids such as cortisol. Evidence: TAS. Frequency: Frequent (HP:0040282). (ORPHA:95613)
- Abnormal kinetic perimetry test (HP:0030591). Evidence: TAS. Frequency: Frequent (HP:0040282). (ORPHA:95613)
- Abnormal static automated perimetry test (HP:0030595). Evidence: TAS. Frequency: Frequent (HP:0040282). (ORPHA:95613)
- Ptosis (HP:0000508): The upper eyelid margin is positioned 3 mm or more lower than usual and covers the superior portion of the iris (objective); or, the upper lid margin obscures at least part of the pupil (subjective). Evidence: TAS. Frequency: Occasional (HP:0040283). (ORPHA:95613)
- Photophobia (HP:0000613): Excessive sensitivity to light with the sensation of discomfort or pain in the eyes due to exposure to bright light. Evidence: TAS. Frequency: Occasional (HP:0040283). (ORPHA:95613)
- Blurred vision (HP:0000622): Lack of sharpness of vision resulting in the inability to see fine detail. Evidence: TAS. Frequency: Occasional (HP:0040283). (ORPHA:95613)
- Decreased response to growth hormone stimulation test (HP:0000824): Insufficient responses to growth hormone (GH) provocation tests. GH deficiency is defined as a serum peak GH concentration less than 10 ng/mL on provocation with a combination of at least two separate stimulation tests. Evidence: TAS. Frequency: Occasional (HP:0040283). (ORPHA:95613)
- Increased circulating prolactin concentration (HP:0000870): The presence of abnormally increased levels of prolactin in the blood. Prolactin is a peptide hormone produced by the anterior pituitary gland that plays a role in breast development and lactation during pregnancy. Evidence: TAS. Frequency: Occasional (HP:0040283). (ORPHA:95613)
- Pallor (HP:0000980): Abnormally pale skin. Evidence: TAS. Frequency: Occasional (HP:0040283). (ORPHA:95613)
- Coma (HP:0001259): The complete absence of wakefulness and consciousness, which is evident through a lack of response to any form of external stimuli. Evidence: TAS. Frequency: Occasional (HP:0040283). (ORPHA:95613)
- Fever (HP:0001945): Body temperature elevated above the normal range. Evidence: TAS. Frequency: Occasional (HP:0040283). (ORPHA:95613)
- Abnormal cerebrospinal fluid morphology (HP:0002921): An abnormality of the cerebrospinal fluid (CSF). Evidence: TAS. Frequency: Occasional (HP:0040283). (ORPHA:95613)
- Reduced visual acuity (HP:0007663). Evidence: TAS. Frequency: Occasional (HP:0040283). (ORPHA:95613)
- Mydriasis (HP:0011499): Abnormal dilatation of the iris. Evidence: TAS. Frequency: Occasional (HP:0040283). (ORPHA:95613)
- Fatigue (HP:0012378): A subjective feeling of tiredness characterized by a lack of energy and motivation. Evidence: TAS. Frequency: Occasional (HP:0040283). (ORPHA:95613)
- Hypopituitarism (HP:0040075). Evidence: TAS. Frequency: Occasional (HP:0040283). (ORPHA:95613)
- Galactorrhea (HP:0100829): Spontaneous flow of milk from the breast, unassociated with childbirth or nursing. Evidence: TAS. Frequency: Occasional (HP:0040283). (ORPHA:95613)
- Elevated circulating growth hormone concentration (HP:0000845): Acromegaly is a condition resulting from overproduction of growth hormone by the pituitary gland in persons with closed epiphyses, and consists chiefly in the enlargement of the distal parts of the body. The circumference of the skull increases, the nose becomes broad, the tongue becomes enlarged, the facial features become coarsened, the mandible grows excessively, and the teeth become separated. The fingers and toes grow chiefly in thickness. Evidence: TAS. Frequency: Very rare (HP:0040284). (ORPHA:95613)
- Central diabetes insipidus (HP:0000863): A form of diabetes insipidus related to a failure of vasopressin (AVP) release from the hypothalamus. Evidence: TAS. Frequency: Very rare (HP:0040284). (ORPHA:95613)
- Excessive daytime somnolence (HP:0001262): A state of abnormally strong desire for sleep during the daytime. Evidence: TAS. Frequency: Very rare (HP:0040284). (ORPHA:95613)
- Confusion (HP:0001289): Lack of clarity and coherence of thought, perception, understanding, or action. Evidence: TAS. Frequency: Very rare (HP:0040284). (ORPHA:95613)
- Normochromic anemia (HP:0001895). Evidence: TAS. Frequency: Very rare (HP:0040284). (ORPHA:95613)
- Abnormal caudate nucleus morphology (HP:0002339): Any structural abnormality of the caudate nucleus. Evidence: TAS. Frequency: Very rare (HP:0040284). (ORPHA:95613)
- Increased circulating cortisol level (HP:0003118): Overproduction of the hormone of cortisol by the adrenal cortex, resulting in a characteristic combination of clinical symptoms termed Cushing syndrome, with truncal obesity, a round, full face, striae atrophicae and acne, muscle weakness, and other features. Evidence: TAS. Frequency: Very rare (HP:0040284). (ORPHA:95613)
- Trigeminal neuralgia (HP:0100661): A neuropathic disorder characterized by episodes of intense pain in the face, originating from the trigeminal nerve. One, two, or all three branches of the nerve may be affected. Evidence: TAS. Frequency: Very rare (HP:0040284). (ORPHA:95613)
These phenotypes are associated with the disease Pituitary apoplexy (ORPHA:95613).